Phenotypes associated with the disease combined oxidative phosphorylation deficiency 36 (OMIM:617950):
- Poor speech (HP:0002465). Evidence: PCS. Frequency: 2/2. (PMID:29576219)
- Upslanted palpebral fissure (HP:0000582): The palpebral fissure inclination is more than two standard deviations above the mean for age (objective); or, the inclination of the palpebral fissure is greater than typical for age. Evidence: PCS. Frequency: 1/2. (PMID:29576219)
- Elevated circulating aspartate aminotransferase concentration (HP:0031956): The concentration of aspartate aminotransferase (AST) in the blood circulation is above the upper limit of normal. Evidence: PCS. Frequency: 1/2. (PMID:29576219)
- Increased circulating lactate concentration (HP:0002151): Abnormally increased level of blood lactate (2-hydroxypropanoic acid). Lactate is produced from pyruvate by lactate dehydrogenase during normal metabolism. The terms lactate and lactic acid are often used interchangeably but lactate (the component measured in blood) is strictly a weak base whereas lactic acid is the corresponding acid. Lactic acidosis is often used clinically to describe elevated lactate but should be reserved for cases where there is a corresponding acidosis (pH below 7.35). Evidence: PCS. Frequency: 2/2. (PMID:29576219)
- Hypotonia (HP:0001252): Hypotonia is an abnormally low muscle tone (the amount of tension or resistance to movement in a muscle). Even when relaxed, muscles have a continuous and passive partial contraction which provides some resistance to passive stretching. Hypotonia thus manifests as diminished resistance to passive stretching. Hypotonia is not the same as muscle weakness, although the two conditions can co-exist. Evidence: PCS. Frequency: 2/2. (PMID:29576219)
- Global developmental delay (HP:0001263): A delay in the achievement of motor or mental milestones in the domains of development of a child, including motor skills, speech and language, cognitive skills, and social and emotional skills. This term should only be used to describe children younger than five years of age. Evidence: PCS. Frequency: 2/2. (PMID:29576219)
- Infantile onset (HP:0003593): Onset of signs or symptoms of disease between 28 days to one year of life. Evidence: PCS. Frequency: 2/2. (PMID:29576219)
- Elevated circulating alanine aminotransferase concentration (HP:0031964): An abnormally high concentration in the circulation of alanine aminotransferase (ALT). Evidence: PCS. Frequency: 1/2. (PMID:29576219)
- Premature skin wrinkling (HP:0100678): The presence of an increased degree of wrinkling (irregular folds and indentations) of the skin as compared with age-related norms. Evidence: PCS. Frequency: 1/2. (PMID:29576219)
- Failure to thrive (HP:0001508): Failure to thrive (FTT) refers to a child whose physical growth is substantially below the norm. Evidence: PCS. Frequency: 1/2. (PMID:29576219)
- Sensorineural hearing impairment (HP:0000407): A type of hearing impairment in one or both ears related to an abnormal functionality of the cochlear nerve. Evidence: PCS. Frequency: 2/2. (PMID:29576219)
- Lower limb muscle weakness (HP:0007340): Weakness of the muscles of the legs. Evidence: PCS. Frequency: 1/2. (PMID:29576219)
- Hypoglycemia (HP:0001943): A decreased concentration of glucose in the blood. Evidence: PCS. Frequency: 2/2. (PMID:29576219)
- Autosomal recessive inheritance (HP:0000007): A mode of inheritance that is observed for traits related to a gene encoded on one of the autosomes (i.e., the human chromosomes 1-22) in which a trait manifests in individuals with two pathogenic alleles, either homozygotes (two copies of the same mutant allele) or compound heterozygotes (whereby each copy of a gene has a distinct mutant allele). Evidence: PCS. (PMID:29576219)
- Aciduria (HP:0012072): Excretion of urine with an acid pH, i.e., having an increased hydrogen ion concentration. Evidence: IEA. (OMIM:617950)
- Headache (HP:0002315): Cephalgia, or pain sensed in various parts of the head, not confined to the area of distribution of any nerve. Evidence: PCS. Frequency: 1/2. (PMID:29576219)
- Exodeviation (HP:0020049): A manifest or latent ocular deviation in which one or both eyes tends to deviate temporally. Evidence: PCS. Frequency: 1/2. (PMID:29576219)
- Low-set ears (HP:0000369): Upper insertion of the ear to the scalp below an imaginary horizontal line drawn between the inner canthi of the eye and extending posteriorly to the ear. Evidence: PCS. Frequency: 1/2. (PMID:29576219)
- Intellectual disability (HP:0001249): The term intellectual disability or intellectual developmental disorder is used to describe significantly sub-average intellectual and adaptive functioning based on clinical assessment and as measured by individually administered, appropriately normed, standardized and validated tests of intellectual functioning and adaptive behavior, with onset during the developmental period from infancy through adolescence. Evidence: PCS. Frequency: 2/2. (PMID:29576219)
- Myalgia (HP:0003326): Pain in muscle. Evidence: PCS. Frequency: 1/2. (PMID:29576219)
- Hyperalaninemia (HP:0003348): An increased concentration of alanine in the blood. Evidence: PCS. Frequency: 1/2. (PMID:29576219)
- Exercise intolerance (HP:0003546): A functional motor deficit where individuals whose responses to the challenges of exercise fail to achieve levels considered normal for their age and gender. Evidence: PCS. Frequency: 1/2. (PMID:29576219)